Phenotypes associated with the disease hearing loss, autosomal dominant 75 (OMIM:618778):
- Abnormal cochlea morphology (HP:0000375): An abnormality of the cochlea. Evidence: PCS. Frequency: 0/4. (PMID:31231791)
- Sensorineural hearing impairment (HP:0000407): A type of hearing impairment in one or both ears related to an abnormal functionality of the cochlear nerve. Evidence: PCS. Frequency: 4/4. Onset: Adult onset (HP:0003581). (PMID:31231791)
- Young adult onset (HP:0011462): Onset of disease at the age of between 16 and 40 years. Evidence: PCS. Frequency: 2/2. (PMID:31231791)
- Autosomal dominant inheritance (HP:0000006): A mode of inheritance that is observed for traits related to a gene encoded on one of the autosomes (i.e., the human chromosomes 1-22) in which a trait manifests in heterozygotes. In the context of medical genetics, an autosomal dominant disorder is caused when a single copy of the mutant allele is present. Males and females are affected equally, and can both transmit the disorder with a risk of 50% for each child of inheriting the mutant allele. Evidence: PCS. (PMID:31231791)